Phenotypes associated with the disease immunodeficiency due to MASP-2 deficiency (OMIM:613791):
- Ulcerative colitis (HP:0100279): A chronic inflammatory bowel disease that includes characteristic ulcers, or open sores, in the colon. The main symptom of active disease is usually constant diarrhea mixed with blood, of gradual onset and intermittent periods of exacerbated symptoms contrasting with periods that are relatively symptom-free. In contrast to Crohn's disease this special form of colitis begins in the distal parts of the rectum, spreads continually upwards and affects only mucose and submucose tissue of the colon. Evidence: PCS. Frequency: 1/1. (PMID:12904520)
- Reduced circulating complement concentration (HP:0004431): An immunodeficiency defined by the absent or suboptimal functioning of one of the complement system proteins. Evidence: PCS. Frequency: 1/1. (PMID:12904520)
- Autosomal recessive inheritance (HP:0000007): A mode of inheritance that is observed for traits related to a gene encoded on one of the autosomes (i.e., the human chromosomes 1-22) in which a trait manifests in individuals with two pathogenic alleles, either homozygotes (two copies of the same mutant allele) or compound heterozygotes (whereby each copy of a gene has a distinct mutant allele). Evidence: TAS. (OMIM:613791)
- Systemic lupus erythematosus (HP:0002725): A chronic, relapsing, inflammatory, and often febrile multisystemic disorder of connective tissue, characterized principally by involvement of the skin, joints, kidneys, and serosal membranes. Evidence: PCS. Frequency: 1/1. (PMID:12904520)
- Recurrent pneumonia (HP:0006532): An increased susceptibility to pneumonia as manifested by a history of recurrent episodes of pneumonia. Evidence: PCS. Frequency: 1/1. (PMID:12904520)